- Rhizomelia (HP:0008905): Disproportionate shortening of the proximal segment of limbs (i.e. the femur and humerus). Evidence: TAS. (OMIM:166990)
- Agenesis of corpus callosum (HP:0001274): Absence of the corpus callosum as a result of the failure of the corpus callosum to develop, which can be the result of a failure in any one of the multiple steps of callosal development including cellular proliferation and migration, axonal growth or glial patterning at the midline. Evidence: IEA. (OMIM:166990)
- Hypertension (HP:0000822): The presence of chronic increased pressure in the systemic arterial system. Evidence: IEA. (OMIM:166990)
- Hydrocephalus (HP:0000238): Hydrocephalus is an active distension of the ventricular system of the brain resulting from inadequate passage of CSF from its point of production within the cerebral ventricles to its point of absorption into the systemic circulation. Evidence: IEA. (OMIM:166990)
- Thrombocytopenia (HP:0001873): A reduction in the number of circulating thrombocytes. Evidence: IEA. (OMIM:166990)
- Autosomal dominant inheritance (HP:0000006): A mode of inheritance that is observed for traits related to a gene encoded on one of the autosomes (i.e., the human chromosomes 1-22) in which a trait manifests in heterozygotes. In the context of medical genetics, an autosomal dominant disorder is caused when a single copy of the mutant allele is present. Males and females are affected equally, and can both transmit the disorder with a risk of 50% for each child of inheriting the mutant allele. Evidence: IEA. (OMIM:166990)
These phenotypes are associated with the disease osteochondrodysplasia, rhizomelic, with callosal agenesis, thrombocytopenia, hydrocephalus, and hypertension (OMIM:166990).